- Decreased body weight (HP:0004325): Abnormally low body weight. Evidence: TAS. (OMIM:617402)
- Nephrocalcinosis (HP:0000121): Nephrocalcinosis is the deposition of calcium salts in renal parenchyma. Evidence: PCS. Frequency: 1/2. (PMID:27023906)
- Strabismus (HP:0000486): A misalignment of the eyes so that the visual axes deviate from bifoveal fixation. The classification of strabismus may be based on a number of features including the relative position of the eyes, whether the deviation is latent or manifest, intermittent or constant, concomitant or otherwise and according to the age of onset and the relevance of any associated refractive error. Evidence: PCS. Frequency: 2/2. (PMID:27023906)
- Short stature (HP:0004322): A height below that which is expected according to age and gender norms. Although there is no universally accepted definition of short stature, many refer to "short stature" as height more than 2 standard deviations below the mean for age and gender (or below the 3rd percentile for age and gender dependent norms). Evidence: TAS. (OMIM:617402)
- Pyloric stenosis (HP:0002021): Pyloric stenosis, also known as infantile hypertrophic pyloric stenosis, is an uncommon condition in infants characterized by abnormal thickening of the pylorus muscles in the stomach leading to gastric outlet obstruction. Clinically infants are well at birth. Then, at 3 to 6 weeks of age, the infants present with projectile vomiting, potentially leading to dehydration and weight loss. Evidence: PCS. Frequency: 1/2. (PMID:27023906)
- Narrow mouth (HP:0000160): Distance between the commissures of the mouth more than 2 SD below the mean. Alternatively, an apparently decreased width of the oral aperture (subjective). Evidence: PCS. Frequency: 1/2. (PMID:27023906)
- Hypotonia (HP:0001252): Hypotonia is an abnormally low muscle tone (the amount of tension or resistance to movement in a muscle). Even when relaxed, muscles have a continuous and passive partial contraction which provides some resistance to passive stretching. Hypotonia thus manifests as diminished resistance to passive stretching. Hypotonia is not the same as muscle weakness, although the two conditions can co-exist. Evidence: PCS. Frequency: 3/3. (PMID:28065471)
- Broad columella (HP:0010761): Increased width of the columella. Evidence: TAS. (OMIM:617402)
- Gowers sign (HP:0003391): A phenomenon whereby patients are not able to stand up without the use of the hands owing to weakness of the proximal muscles of the lower limbs. Evidence: PCS. Frequency: 1/2. (PMID:27023906)
- Type II transferrin isoform profile (HP:0012301): Abnormal transferrin isoform profile consistent with a type II congenital disorder of glycosylation. Evidence: PCS. Frequency: 2/2. (PMID:28065471)
- Nystagmus (HP:0000639): Rhythmic, involuntary oscillations of one or both eyes related to abnormality in fixation, conjugate gaze, or vestibular mechanisms. Evidence: TAS. (OMIM:617402)
- Hypertelorism (HP:0000316): Interpupillary distance more than 2 SD above the mean (alternatively, the appearance of an increased interpupillary distance or widely spaced eyes). Evidence: PCS. Frequency: 5/6. (PMID:27023906;PMID:28065471)
- Overlapping toe (HP:0001845): Describes a foot digit resting on the dorsal surface of an adjacent digit when the foot is at rest. Initially clawing may be dynamic and only noticeable on walking. Over time the plantar plate tears, subluxation occurs at the metatarsophalangeal joint (MTPJ), and the deformity becomes permanent. Evidence: PCS. Frequency: 2/2. (PMID:27023906)
- Dental crowding (HP:0000678): Changes in alignment of teeth in the dental arch. Evidence: PCS. Frequency: 2/2. (PMID:28065471)
- Muscle weakness (HP:0001324): Reduced strength of muscles. Evidence: PCS. Frequency: 1/2. (PMID:27023906)
- Pes planus (HP:0001763): A foot where the longitudinal arch of the foot is in contact with the ground or floor when the individual is standing; or, in a patient lying supine, a foot where the arch is in contact with the surface of a flat board pressed against the sole of the foot by the examiner with a pressure similar to that expected from weight bearing; or, the height of the arch is reduced. Evidence: TAS. (OMIM:617402)
- Laryngomalacia (HP:0001601): Laryngomalacia is a congenital abnormality of the laryngeal cartilage in which the cartilage is floppy and prolapses over the larynx during inspiration. Evidence: TAS. (OMIM:617402)
- Hand clenching (HP:0001188): An abnormal hand posture in which the hands are clenched to fists. All digits held completely flexed at the metacarpophalangeal and interphalangeal joints. In prenatal sonography of the fetal clenched hand, the index finger overlaps a clenched fist formed by the other digits. The proximal interphalangeal articulation of the index finger is flexed and ulnarly deviated, and the thumb is adducted. Evidence: TAS. (OMIM:617402)
- Kyphoscoliosis (HP:0002751): An abnormal curvature of the spine in both a coronal (lateral) and sagittal (back-to-front) plane. Evidence: PCS. Frequency: 2/4. (PMID:28065471)
- Hip dysplasia (HP:0001385): The presence of developmental dysplasia of the hip. Evidence: PCS. Frequency: 2/3. (PMID:28065471)
- Micropenis (HP:0000054): Abnormally small penis. At birth, the normal penis is about 3 cm (stretched length from pubic tubercle to tip of penis) with micropenis less than 2.0-2.5 cm. Evidence: PCS. Frequency: 1/2. (PMID:27023906)
- Joint hypermobility (HP:0001382): The capability that a joint (or a group of joints) has to move, passively and/or actively, beyond normal limits along physiological axes. Evidence: TAS. (OMIM:617402)
- Patent ductus arteriosus after birth at term (HP:0011648): Abnormal persistent patency of the ductus arteriosus in postnatal life when birth was at 37 completed weeks of gestation or greater. Evidence: PCS. Frequency: 1/2. (PMID:27023906)
- Tricuspid regurgitation (HP:0005180): Failure of the tricuspid valve to close sufficiently upon contraction of the right ventricle, causing blood to regurgitate (flow backward) into the right atrium. Evidence: PCS. Frequency: 1/2. (PMID:27023906)
- Wide nasal base (HP:0012810): Increased distance between the attachments of the alae nasi to the face. Evidence: PCS. Frequency: 4/4. (PMID:28065471)
- Camptodactyly (HP:0012385): The distal interphalangeal joint and/or the proximal interphalangeal joint of the fingers or toes cannot be extended to 180 degrees by either active or passive extension. Evidence: PCS. Frequency: 1/2. (PMID:27023906)
- Joint contracture (HP:0034392): A limitation in the passive range of motion of a joint resulting from loss of elasticity in the periarticular tissues owing to structural changes of non-bony tissues, such as muscles, tendons, ligaments, joint capsules or skin. A contracture prevents movement of the associated body part. Evidence: PCS. Frequency: 1/4. (PMID:28065471)
- Knee flexion contracture (HP:0006380): A type of knee joint contracture in which the knee is in a fixed bent (flexed) configuration such that it cannot be straightened actively or passively. Evidence: TAS. (OMIM:617402)
- Premature sagging cheeks (HP:0034273): Drooping or sinking of tissues of the cheeks more than would be expected at a given age. Sagging can occur due to a relative excess of skin and/or lack of elastic recoil as well as fat accumulation. Evidence: PCS. Frequency: 2/2. (PMID:27023906)
- Median cleft palate (HP:0009099): Cleft palate of the midline of the palate. Evidence: PCS. Frequency: 2/2. (PMID:28065471)
- Hypoplasia of the maxilla (HP:0000327): Abnormally small dimension of the Maxilla. Usually creating a malocclusion or malalignment between the upper and lower teeth or resulting in a deficient amount of projection of the base of the nose and lower midface region. Evidence: PCS. Frequency: 1/2. (PMID:27023906)
- Autosomal recessive inheritance (HP:0000007): A mode of inheritance that is observed for traits related to a gene encoded on one of the autosomes (i.e., the human chromosomes 1-22) in which a trait manifests in individuals with two pathogenic alleles, either homozygotes (two copies of the same mutant allele) or compound heterozygotes (whereby each copy of a gene has a distinct mutant allele). Evidence: PCS. (PMID:27023906)
- Reduced subcutaneous adipose tissue (HP:0003758): A reduced amount of fat tissue in the lowest layer of the integument. This feature can be appreciated by a reduced skinfold thickness. Evidence: TAS. (OMIM:617402)
- Spontaneous pneumothorax (HP:0002108): Pneumothorax occurring without traumatic injury to the chest or lung. Evidence: PCS. Frequency: 2/3. (PMID:28065471)
- Aortic regurgitation (HP:0001659): An insufficiency of the aortic valve, leading to regurgitation (backward flow) of blood from the aorta into the left ventricle. Evidence: TAS. (OMIM:617402)
- Convex nasal ridge (HP:0000444): Nasal ridge curving anteriorly to an imaginary line that connects the nasal root and tip. The nose appears often also prominent, and the columella low. Evidence: PCS. Frequency: 6/6. (PMID:27023906;PMID:28065471)
- Narrow naris (HP:0009933): Slender, slit-like aperture of the nostril. Evidence: TAS. (OMIM:617402)
- Bilateral cryptorchidism (HP:0008689): Absence of both testes from the scrotum owing to failure of the testis or testes to descend through the inguinal canal to the scrotum. Evidence: TAS. (OMIM:617402)
- Prominent superficial veins (HP:0001015): A condition in which superficial veins (i.e., veins just under the skin) are more conspicuous or noticeable than normal. Evidence: PCS. Frequency: 2/2. (PMID:27023906)
- Low-set ears (HP:0000369): Upper insertion of the ear to the scalp below an imaginary horizontal line drawn between the inner canthi of the eye and extending posteriorly to the ear. Evidence: PCS. Frequency: 4/4. (PMID:28065471)
- Triangular face (HP:0000325): Facial contour, as viewed from the front, triangular in shape, with breadth at the temples and tapering to a narrow chin. Evidence: PCS. Frequency: 4/4. (PMID:28065471)
- Patent foramen ovale (HP:0001655): Failure of the foramen ovale to seal postnatally, leaving a potential conduit between the left and right cardiac atria. Evidence: PCS. Frequency: 1/2. (PMID:27023906)
- Congenital onset (HP:0003577): A phenotypic abnormality that is present at birth. Evidence: PCS. Frequency: 6/6. (PMID:27023906;PMID:28065471)
- Long philtrum (HP:0000343): Distance between nasal base and midline upper lip vermilion border more than 2 SD above the mean. Alternatively, an apparently increased distance between nasal base and midline upper lip vermilion border. Evidence: PCS. Frequency: 2/2. (PMID:28065471)
- Anteverted nares (HP:0000463): Anteriorly-facing nostrils viewed with the head in the Frankfurt horizontal and the eyes of the observer level with the eyes of the subject. This gives the appearance of an upturned nose (upturned nasal tip). Evidence: PCS. Frequency: 2/2. (PMID:28065471)
- Thoracic aortic aneurysm (HP:0012727): An abnormal localized widening (dilatation) of the thoracic aorta. Evidence: PCS. Frequency: 1/4. (PMID:28065471)
- Blepharophimosis (HP:0000581): A fixed reduction in the vertical distance between the upper and lower eyelids with short palpebral fissures. Evidence: PCS. Frequency: 2/2. (PMID:27023906)
- Complete right bundle branch block (HP:0011712): A conduction block of the right branch of the bundle of His. This manifests as a prolongation of the QRS complex (greater than 0.12 s) with delayed activation of the right ventricle and terminal delay on the EKG. Evidence: IEA. (OMIM:617402)
- Concave nasal ridge (HP:0011120): Nasal ridge curving posteriorly to an imaginary line that connects the nasal root and tip. Evidence: PCS. Frequency: 1/2. (PMID:27023906)
- High palate (HP:0000218): Height of the palate more than 2 SD above the mean (objective) or palatal height at the level of the first permanent molar more than twice the height of the teeth (subjective). Evidence: TAS. (OMIM:617402)
- Broad nasal tip (HP:0000455): Increase in width of the nasal tip. Evidence: TAS. (OMIM:617402)
- Cutis laxa (HP:0000973): Wrinkled, redundant, inelastic and sagging skin. Evidence: PCS. Frequency: 5/6. (PMID:27023906;PMID:28065471)
- Oligohydramnios (HP:0001562): Diminished amniotic fluid volume in pregnancy. Evidence: PCS. Frequency: 1/2. (PMID:27023906)
- Talipes equinovarus (HP:0001762): Talipes equinovarus (also called clubfoot) typically has four main components: inversion and adduction of the forefoot; inversion of the heel and hindfoot; equinus (limitation of extension) of the ankle and subtalar joint; and internal rotation of the leg. Evidence: TAS. (OMIM:617402)
- Biventricular hypertrophy (HP:0200128): Thickening of the heart walls in both ventricles. Evidence: IEA. (OMIM:617402)
- Small forehead (HP:0000350): The presence of a forehead that is abnormally small. Evidence: PCS. Frequency: 6/6. (PMID:27023906;PMID:28065471)
- Malar flattening (HP:0000272): Underdevelopment of the malar prominence of the jugal bone (zygomatic bone in mammals), appreciated in profile, frontal view, and/or by palpation. Evidence: PCS. Frequency: 1/2. (PMID:27023906)
- Disproportionate tall stature (HP:0001519): A tall and slim body build with increased arm span to height ratio (>1.05) and a reduced upper-to-lower segment ratio (<0.85), i.e., unusually long arms and legs. The extremities as well as the hands and feet are unusually slim. Evidence: PCS. Frequency: 2/4. (PMID:28065471)
- Periorbital fullness (HP:0000629): Increase in periorbital soft tissue. Evidence: PCS. Frequency: 2/2. (PMID:27023906)
- Pointed chin (HP:0000307): A marked tapering of the lower face to the chin. Evidence: PCS. Frequency: 4/4. (PMID:28065471)
- Atrial septal defect (HP:0001631): Atrial septal defect (ASD) is a congenital abnormality of the interatrial septum that enables blood flow between the left and right atria via the interatrial septum. Evidence: TAS. (OMIM:617402)
- Cryptorchidism (HP:0000028): Testis in inguinal canal. That is, absence of one or both testes from the scrotum owing to failure of the testis or testes to descend through the inguinal canal to the scrotum. Evidence: PCS. Frequency: 1/1. (PMID:27023906)
- Mandibular prognathia (HP:0000303): Abnormal prominence of the chin related to increased length of the mandible. Evidence: PCS. Frequency: 1/2. (PMID:27023906)
- Mitral valve prolapse (HP:0001634): One or both of the leaflets (cusps) of the mitral valve bulges back into the left atrium upon contraction of the left ventricle. Evidence: TAS. (OMIM:617402)
- Entropion (HP:0000621): An abnormal inversion (turning inward) of the eyelid (usually the lower) towards the globe. Entropion is usually acquired as a result of involutional or cicatricial processes but may occasionally be congenital. Evidence: PCS. Frequency: 6/6. (PMID:27023906;PMID:28065471)
These phenotypes are associated with the disease autosomal recessive cutis laxa type 2C (OMIM:617402).